Phenotypes associated with the disease Pemphigus vulgaris (ORPHA:704):
- Atypical scarring of skin (HP:0000987): Atypically scarred skin . Evidence: TAS. Frequency: Very frequent (HP:0040281). (ORPHA:704)
- Urticaria (HP:0001025): Raised, well-circumscribed areas of erythema and edema involving the dermis and epidermis. Urticaria is intensely pruritic, and blanches completely with pressure. Evidence: TAS. Frequency: Very frequent (HP:0040281). (ORPHA:704)
- Weight loss (HP:0001824): Reduction of total body weight. Evidence: TAS. Frequency: Very frequent (HP:0040281). (ORPHA:704)
- Recurrent infections (HP:0002719): Increased susceptibility to infections as manifested by repeated bouts of infection. Evidence: TAS. Frequency: Very frequent (HP:0040281). (ORPHA:704)
- Autoimmunity (HP:0002960): The occurrence of an immune reaction against the organism's own cells or tissues. Evidence: TAS. Frequency: Very frequent (HP:0040281). (ORPHA:704)
- Feeding difficulties in infancy (HP:0008872): Impaired feeding performance of an infant as manifested by difficulties such as weak and ineffective sucking, brief bursts of sucking, and falling asleep during sucking. There may be difficulties with chewing or maintaining attention. Evidence: TAS. Frequency: Very frequent (HP:0040281). (ORPHA:704)
- Erosion of oral mucosa (HP:0031446): Loss of the superficial layer of the oral mucosa usually resulting in a shallow or crusted lesion. Evidence: TAS. Frequency: Very frequent (HP:0040281). (ORPHA:704)
- Acantholysis (HP:0100792): The loss of intercellular connections, such as desmosomes, resulting in loss of cohesion between keratinocytes. Evidence: TAS. Frequency: Very frequent (HP:0040281). (ORPHA:704)
- Recurrent cutaneous abscess formation (HP:0100838): An increased susceptibility to cutaneous abscess formation, as manifested by a medical history of recurrent cutaneous abscesses. Evidence: TAS. Frequency: Very frequent (HP:0040281). (ORPHA:704)
- Oral mucosal blisters (HP:0200097): Blisters arising in the mouth. Evidence: TAS. Frequency: Very frequent (HP:0040281). (ORPHA:704)
- Depression (HP:0000716): Frequently experiencing feelings of being down, miserable, and/or hopeless; struggling to recover from these moods; having a pessimistic outlook on the future; feeling a pervasive sense of shame; having a low self-worth; experiencing thoughts of suicide and engaging in suicidal behavior. Evidence: TAS. Frequency: Frequent (HP:0040282). (ORPHA:704)
- Anxiety (HP:0000739): Intense feelings of nervousness, tension, or panic often arise in response to interpersonal stresses. There is worry about the negative effects of past unpleasant experiences and future negative possibilities. Individuals may feel fearful, apprehensive, or threatened by uncertainty, and they may also have fears of falling apart or losing control. Evidence: TAS. Frequency: Frequent (HP:0040282). (ORPHA:704)
- Abnormal blistering of the skin (HP:0008066): The presence of one or more bullae on the skin, defined as fluid-filled blisters more than 5 mm in diameter with thin walls. Evidence: TAS. Frequency: Frequent (HP:0040282). (ORPHA:704)
- Feeding difficulties (HP:0011968): Impaired ability to eat related to problems gathering food and getting ready to suck, chew, or swallow it. Evidence: TAS. Frequency: Frequent (HP:0040282). (ORPHA:704)
- Suprabasal cleavage (HP:0034194): Cleavage within the suprabasal cell layer of the epidermis, which lies directly above the basal layer and is composed of five to ten layers of cells. Evidence: TAS. Frequency: Frequent (HP:0040282). (ORPHA:704)
- Anti-desmoglein-1 antibody positivity (HP:4000013): The presence of autoantibodies (immunoglobulins) in the serum that react against desmoglein-1, a dermal cell adhesion molecule. Evidence: TAS. Frequency: Frequent (HP:0040282). (ORPHA:704)
- Anti-desmoglein-3 antibody positivity (HP:4000014): The presence of autoantibodies (immunoglobulins) in the serum that react against desmoglein-3, a dermal cell adhesion molecule. Evidence: TAS. Frequency: Frequent (HP:0040282). (ORPHA:704)
- Alopecia of scalp (HP:0002293). Evidence: TAS. Frequency: Occasional (HP:0040283). (ORPHA:704)
- Pain (HP:0012531): An unpleasant sensory and emotional experience associated with actual or potential tissue damage, or described in terms of such damage. Evidence: TAS. Frequency: Occasional (HP:0040283). (ORPHA:704)
- Urticarial plaque (HP:0030351): A well-circumscribed, intensely pruritic, raised wheal (edema of the superficial skin) typically 1 to 2 cm in diameter. Evidence: TAS. Frequency: Very rare (HP:0040284). (ORPHA:704)